Phenotypes associated with the disease Glutaric acidemia type 3 (ORPHA:35706):
- Glutaric aciduria (HP:0003150): The concentration of glutaric acid in the urine, normalized for urine concentration, is above the upper limit of normal. Evidence: TAS. Frequency: Obligate (HP:0040280). (ORPHA:35706)
- Abnormal circulating enzyme concentration (HP:0011021): Any deviation from the normal concentration of an enzyme in the blood circulation. Evidence: TAS. Frequency: Very frequent (HP:0040281). (ORPHA:35706)
- Sacral dimple (HP:0000960): A cutaneous indentation resulting from tethering of the skin to underlying structures (bone) of the intergluteal cleft. Evidence: TAS. Frequency: Occasional (HP:0040283). (ORPHA:35706)
- Lethargy (HP:0001254): A state of fatigue, either physical or mental slowness and sluggishness, with difficulties in initiating or performing simple tasks. Distinguished from apathy which implies indifference and a lack of desire or interest in the task. A person with lethargy may have the desire, but not the energy to engage in personal or socially relevant tasks. Evidence: TAS. Frequency: Occasional (HP:0040283). (ORPHA:35706)
- Global developmental delay (HP:0001263): A delay in the achievement of motor or mental milestones in the domains of development of a child, including motor skills, speech and language, cognitive skills, and social and emotional skills. This term should only be used to describe children younger than five years of age. Evidence: TAS. Frequency: Occasional (HP:0040283). (ORPHA:35706)
- Specific learning disability (HP:0001328): Impairment of certain skills such as reading or writing, coordination, self-control, or attention that interfere with the ability to learn. The impairment is not related to a global deficiency of intelligence. Evidence: TAS. Frequency: Occasional (HP:0040283). (ORPHA:35706)
- Failure to thrive (HP:0001508): Failure to thrive (FTT) refers to a child whose physical growth is substantially below the norm. Evidence: TAS. Frequency: Occasional (HP:0040283). (ORPHA:35706)
- Ketoacidosis (HP:0001993): Acidosis resulting from accumulation of ketone bodies. Evidence: TAS. Frequency: Occasional (HP:0040283). (ORPHA:35706)
- Abnormal cerebral white matter morphology (HP:0002500): An abnormality of the cerebral white matter. Evidence: TAS. Frequency: Occasional (HP:0040283). (ORPHA:35706)
- Abnormal periventricular white matter morphology (HP:0002518): A structural abnormality of the myelinated axons (white matter) located near the cerebral ventricles. Evidence: TAS. Frequency: Occasional (HP:0040283). (ORPHA:35706)
- Ketonuria (HP:0002919): High levels of ketone bodies (acetoacetic acid, beta-hydroxybutyric acid, and acetone) in the urine. Ketone bodies are insignificant in the blood and urine of normal individuals in the postprandial or overnight-fasted state. Evidence: TAS. Frequency: Occasional (HP:0040283). (ORPHA:35706)
- Elevated circulating glutaric acid concentration (HP:0003530): An increased concentration of glutaric acid in the blood. Evidence: TAS. Frequency: Occasional (HP:0040283). (ORPHA:35706)
- Impulsivity (HP:0100710): Acting on the spur of the moment or on a momentary basis without consideration of outcomes; having difficulty establishing or following plans; experiencing a sense of urgency and engaging in behavior that is uninhibited, cannot be inhibited, and is uncontrolled. The possibility of repression is inconceivable. Evidence: TAS. Frequency: Occasional (HP:0040283). (ORPHA:35706)